Phenotypes associated with the disease Rift valley fever (ORPHA:319251):
- Fever (HP:0001945): Body temperature elevated above the normal range. Evidence: TAS. Frequency: Very frequent (HP:0040281). (ORPHA:319251)
- Increased circulating IgG concentration (HP:0003237): An abnormally increased level of immunoglobulin G in blood. Evidence: TAS. Frequency: Very frequent (HP:0040281). (ORPHA:319251)
- Viremia (HP:0020071): The presence of virus in the blood. Evidence: TAS. Frequency: Very frequent (HP:0040281). (ORPHA:319251)
- Anorexia (HP:0002039): Lack of desire to eat (loss of appetite). Evidence: TAS. Frequency: Frequent (HP:0040282). (ORPHA:319251)
- Abnormality of the eye (HP:0000478): Any abnormality of the eye, including location, spacing, and intraocular abnormalities. Evidence: TAS. Frequency: Occasional (HP:0040283). (ORPHA:319251)
- Retinal hemorrhage (HP:0000573): Bleeding located within the retina. Retinal hemorrhages range from the smallest dot and blot hemorrhage to massive sub-hyaloid hemorrhage. Evidence: TAS. Frequency: Occasional (HP:0040283). (ORPHA:319251)
- Scotoma (HP:0000575): A regional and pathological increase of the light detection threshold in any region of the visual field surrounded by a field of normal or relatively well-preserved vision. Evidence: TAS. Frequency: Occasional (HP:0040283). (ORPHA:319251)
- Photophobia (HP:0000613): Excessive sensitivity to light with the sensation of discomfort or pain in the eyes due to exposure to bright light. Evidence: TAS. Frequency: Occasional (HP:0040283). (ORPHA:319251)
- Muscle weakness (HP:0001324): Reduced strength of muscles. Evidence: TAS. Frequency: Occasional (HP:0040283). (ORPHA:319251)
- Increased circulating IgM concentration (HP:0003496): An abnormally increased level of immunoglobulin M in blood. Evidence: TAS. Frequency: Occasional (HP:0040283). (ORPHA:319251)
- Reduced visual acuity (HP:0007663). Evidence: TAS. Frequency: Occasional (HP:0040283). (ORPHA:319251)
- Retinal vasculitis (HP:0025188): Inflammation of retinal blood vessels as manifested by perivascular sheathing or cuffing, vascular leakage and/or occlusion. It can affect veins, arteries or both. Evidence: TAS. Frequency: Occasional (HP:0040283). (ORPHA:319251)
- Retinitis (HP:0032118): Inflammation of the retina of the eye. Evidence: TAS. Frequency: Occasional (HP:0040283). (ORPHA:319251)
- Periodic fever (HP:0032323): Episodic fever that recurs at regular intervals. Evidence: TAS. Frequency: Occasional (HP:0040283). (ORPHA:319251)
- Ocular pain (HP:0200026): An unpleasant sensation characterized by physical discomfort (such as pricking, throbbing, or aching) localized to the eye. Evidence: TAS. Frequency: Occasional (HP:0040283). (ORPHA:319251)
- Gingival bleeding (HP:0000225): Hemorrhage affecting the gingiva. Evidence: TAS. Frequency: Very rare (HP:0040284). (ORPHA:319251)
- Uveitis (HP:0000554): Inflammation of one or all portions of the uveal tract. Evidence: TAS. Frequency: Very rare (HP:0040284). (ORPHA:319251)
- Hallucinations (HP:0000738): Perceptions in a conscious and awake state that, in the absence of external stimuli, have qualities of real perception. These perceptions are vivid, substantial, and located in external objective space. Evidence: TAS. Frequency: Very rare (HP:0040284). (ORPHA:319251)
- Hematuria (HP:0000790): The presence of blood in the urine. Hematuria may be gross hematuria (visible to the naked eye) or microscopic hematuria (detected by dipstick or microscopic examination of the urine). Evidence: TAS. Frequency: Very rare (HP:0040284). (ORPHA:319251)
- Jaundice (HP:0000952): Yellow pigmentation of the skin due to bilirubin, which in turn is the result of increased bilirubin concentration in the bloodstream. Evidence: TAS. Frequency: Very rare (HP:0040284). (ORPHA:319251)
- Skin rash (HP:0000988): A red eruption of the skin. Evidence: TAS. Frequency: Very rare (HP:0040284). (ORPHA:319251)
- Hemiparesis (HP:0001269): Loss of strength in the arm, leg, and sometimes face on one side of the body. Hemiplegia refers to a complete loss of strength, whereas hemiparesis refers to an incomplete loss of strength. Evidence: TAS. Frequency: Very rare (HP:0040284). (ORPHA:319251)
- Thrombocytopenia (HP:0001873): A reduction in the number of circulating thrombocytes. Evidence: TAS. Frequency: Very rare (HP:0040284). (ORPHA:319251)
- Abnormal bleeding (HP:0001892): An abnormal susceptibility to bleeding, often referred to as a bleeding diathesis. A bleeding diathesis may be related to vascular, platelet and coagulation defects. Evidence: TAS. Frequency: Very rare (HP:0040284). (ORPHA:319251)
- Anemia (HP:0001903): A reduction in erythrocytes volume or hemoglobin concentration. Evidence: TAS. Frequency: Very rare (HP:0040284). (ORPHA:319251)
- Abnormal thrombosis (HP:0001977): Venous or arterial thrombosis (formation of blood clots) of spontaneous nature and which cannot be fully explained by acquired risk (e.g. atherosclerosis). Evidence: TAS. Frequency: Very rare (HP:0040284). (ORPHA:319251)
- Hematemesis (HP:0002248): The vomiting of blood. Evidence: TAS. Frequency: Very rare (HP:0040284). (ORPHA:319251)
- Melena (HP:0002249): The passage of blackish, tarry feces associated with gastrointestinal hemorrhage. Melena occurs if the blood remains in the colon long enough for it to be broken down by colonic bacteria. One degradation product, hematin, imbues the stool with a blackish color. Thus, melena generally occurs with bleeding from the upper gastrointestinal tract (e.g., stomach ulcers or duodenal ulcers), since the blood usually remains in the gut for a longer period of time than with lower gastrointestinal bleeding. Evidence: TAS. Frequency: Very rare (HP:0040284). (ORPHA:319251)
- Headache (HP:0002315): Cephalgia, or pain sensed in various parts of the head, not confined to the area of distribution of any nerve. Evidence: TAS. Frequency: Very rare (HP:0040284). (ORPHA:319251)
- Vertigo (HP:0002321): An abnormal sensation of spinning while the body is actually stationary. Evidence: TAS. Frequency: Very rare (HP:0040284). (ORPHA:319251)
- Infectious encephalitis (HP:0002383): A disorder of the brain caused by an infectious agent that presents with fever, headache, and an altered level of consciousness. There may also be focal or multifocal neurologic deficits, and focal or generalized seizure activity. Evidence: TAS. Frequency: Very rare (HP:0040284). (ORPHA:319251)
- Paraparesis (HP:0002385): Weakness or partial paralysis in the lower limbs. Evidence: TAS. Frequency: Very rare (HP:0040284). (ORPHA:319251)
- Elevated circulating hepatic transaminase concentration (HP:0002910): Elevations of the levels of SGOT and SGPT in the serum. SGOT (serum glutamic oxaloacetic transaminase) and SGPT (serum glutamic pyruvic transaminase) are transaminases primarily found in the liver and heart and are released into the bloodstream as the result of liver or heart damage. SGOT and SGPT are used clinically mainly as markers of liver damage. Evidence: TAS. Frequency: Very rare (HP:0040284). (ORPHA:319251)
- Back pain (HP:0003418): An unpleasant sensation characterized by physical discomfort (such as pricking, throbbing, or aching) localized to the back. Evidence: TAS. Frequency: Very rare (HP:0040284). (ORPHA:319251)
- Paralysis (HP:0003470): Paralysis of voluntary muscles means loss of contraction due to interruption of one or more motor pathways from the brain to the muscle fibers. Although the word paralysis is often used interchangeably to mean either complete or partial loss of muscle strength, it is preferable to use paralysis or plegia for complete or severe loss of muscle strength, and paresis for partial or slight loss. Motor paralysis results from deficits of the upper motor neurons (corticospinal, corticobulbar, or subcorticospinal). Motor paralysis is often accompanied by an impairment in the facility of movement. Evidence: TAS. Frequency: Very rare (HP:0040284). (ORPHA:319251)
- Excessive salivation (HP:0003781): Excessive production of saliva. Evidence: TAS. Frequency: Very rare (HP:0040284). (ORPHA:319251)
- Reduced consciousness (HP:0004372): Abnormally diminished level of attention, responsiveness, or wakefulness. Evidence: TAS. Frequency: Very rare (HP:0040284). (ORPHA:319251)
- Miscarriage (HP:0005268): A pregnancy that ends at a stage in which the fetus is incapable of surviving on its own, defined as the spontaneous loss of a fetus before the 22th week of pregnancy. Evidence: TAS. Frequency: Very rare (HP:0040284). (ORPHA:319251)
- Prolonged whole-blood clotting time (HP:0005542): An abnormal prolongation (delay) in the time required by whole blood to produce a visible clot. Evidence: TAS. Frequency: Very rare (HP:0040284). (ORPHA:319251)
- Hepatitis (HP:0012115): Inflammation of the liver. Evidence: TAS. Frequency: Very rare (HP:0040284). (ORPHA:319251)
- CSF pleocytosis (HP:0012229): An increased white blood cell count in the cerebrospinal fluid. Evidence: TAS. Frequency: Very rare (HP:0040284). (ORPHA:319251)
- Decerebrate rigidity (HP:0025013): A type of rigidity that is manifested by an exaggerated extensor posture of all extremities. Evidence: TAS. Frequency: Very rare (HP:0040284). (ORPHA:319251)
- Severe viral infection (HP:0031691): An unusually severe viral infection. Evidence: TAS. Frequency: Very rare (HP:0040284). (ORPHA:319251)
- Macular edema (HP:0040049): Thickening of the retina that takes place due to accumulation of extracellular fluid in the macula as a nonspecific response to blood-retinal barrier breakdown. It can either have a cystoid aspect in the fovea, or a more diffuse aspect. Evidence: TAS. Frequency: Very rare (HP:0040284). (ORPHA:319251)